- Ependymoma (HP:0002888): The presence of an ependymoma of the central nervous system. Evidence: TAS. Frequency: Obligate (HP:0040280). (ORPHA:251639)
- Migraine (HP:0002076): Migraine is a chronic neurological disorder characterized by episodic attacks of headache and associated symptoms. Evidence: TAS. Frequency: Frequent (HP:0040282). (ORPHA:251639)
- Pain (HP:0012531): An unpleasant sensory and emotional experience associated with actual or potential tissue damage, or described in terms of such damage. Evidence: TAS. Frequency: Frequent (HP:0040282). (ORPHA:251639)
- Abnormal cell morphology (HP:0025461): Any anomaly of cell structure. Evidence: TAS. Frequency: Frequent (HP:0040282). (ORPHA:251639)
- Seizure (HP:0001250): A seizure is an intermittent abnormality of nervous system physiology characterized by a transient occurrence of signs and/or symptoms due to abnormal excessive or synchronous neuronal activity in the brain. Evidence: TAS. Frequency: Occasional (HP:0040283). (ORPHA:251639)
- Gait disturbance (HP:0001288): The term gait disturbance can refer to any disruption of the ability to walk. Evidence: TAS. Frequency: Occasional (HP:0040283). (ORPHA:251639)
- Vomiting (HP:0002013): Forceful ejection of the contents of the stomach through the mouth by means of a series of involuntary spasmic contractions. Evidence: TAS. Frequency: Occasional (HP:0040283). (ORPHA:251639)
- Distal muscle weakness (HP:0002460): Reduced strength of the musculature of the distal extremities. Evidence: TAS. Frequency: Occasional (HP:0040283). (ORPHA:251639)
- Spinal cord tumor (HP:0010302): A neoplasm affecting the spinal cord. Evidence: TAS. Frequency: Occasional (HP:0040283). (ORPHA:251639)
- Dysesthesia (HP:0012534): Painful sensations elicited by a nonpainful cutaneous stimulus such as a light touch or gentle stroking over affected areas of the body. Sometimes referred to as hyperpathia or hyperalgesia. Often perceived as an intense burning, dyesthesias may outlast the stimulus by several seconds. Evidence: TAS. Frequency: Occasional (HP:0040283). (ORPHA:251639)
- Supratentorial neoplasm (HP:0030693): A benign or malignant neoplasm that occurs within the intracranial cavity above the tentorium cerebelli. Evidence: TAS. Frequency: Occasional (HP:0040283). (ORPHA:251639)
- Neoplasm of the liver (HP:0002896): A tumor (abnormal growth of tissue) of the liver. Evidence: TAS. Frequency: Very rare (HP:0040284). (ORPHA:251639)
- Neoplasm of the breast (HP:0100013): A tumor (abnormal growth of tissue) of the breast. Evidence: TAS. Frequency: Very rare (HP:0040284). (ORPHA:251639)
- Neoplasm of the lung (HP:0100526): Tumor of the lung. Evidence: TAS. Frequency: Very rare (HP:0040284). (ORPHA:251639)
- Ovarian neoplasm (HP:0100615): A tumor (abnormal growth of tissue) of the ovary. Evidence: TAS. Frequency: Very rare (HP:0040284). (ORPHA:251639)
These phenotypes are associated with the disease Subependymoma (ORPHA:251639).